- Typified by somatic mosaicism (HP:0001442): Description of conditions in which affected individuals typically display somatic mosaicism, i.e., genetically distinct populations of somatic cells in a given organism caused by DNA mutations, epigenetic alterations of DNA, chromosomal abnormalities or the spontaneous reversion of inherited mutations. In many conditions typified by somatic mosaicism, constitutive mutation is lethal and cases are exclusively or predominantly mosaic. Evidence: PCS. (PMID:15884099)
- Histiocytoma (HP:0012315): A neoplasm containing histiocytes. Evidence: PCS. (PMID:15884099)
These phenotypes are associated with the disease histiocytoma, Angiomatoid fibrous (OMIM:612160).